Phenotypes associated with the disease anencephaly 1 (OMIM:206500):
- Anencephaly (HP:0002323): Anencephaly is a developmental anomaly characterized by a fetus that has no calvarium, with a lack of most or all of the fetus' brain tissue. Anencephaly belongs to a collective group known as neural tube defects (NTD) and is a result of the neural tube failing to close in its rostral end during fetal development. Evidence: PCS. Frequency: 1/1. Onset: Congenital onset (HP:0003577). (PMID:28087737)
- Congenital onset (HP:0003577): A phenotypic abnormality that is present at birth. Evidence: PCS. (PMID:28087737)
- Autosomal recessive inheritance (HP:0000007): A mode of inheritance that is observed for traits related to a gene encoded on one of the autosomes (i.e., the human chromosomes 1-22) in which a trait manifests in individuals with two pathogenic alleles, either homozygotes (two copies of the same mutant allele) or compound heterozygotes (whereby each copy of a gene has a distinct mutant allele). Evidence: PCS. (PMID:28087737)
- Spina bifida (HP:0002414): Incomplete closure of the embryonic neural tube, whereby some vertebral arches remain unfused and open. The mildest form is spina bifida occulta, followed by meningocele and meningomyelocele. Evidence: PCS. Frequency: 1/1. (PMID:28087737)